- Widely-spaced maxillary central incisors (HP:0001566): Increased distance between the maxillary central permanent incisor tooth. Evidence: IEA. (OMIM:125900)
- Autosomal dominant inheritance (HP:0000006): A mode of inheritance that is observed for traits related to a gene encoded on one of the autosomes (i.e., the human chromosomes 1-22) in which a trait manifests in heterozygotes. In the context of medical genetics, an autosomal dominant disorder is caused when a single copy of the mutant allele is present. Males and females are affected equally, and can both transmit the disorder with a risk of 50% for each child of inheriting the mutant allele. Evidence: IEA. (OMIM:125900)
- Diastema (HP:0000699): Increased space between two adjacent teeth in the same dental arch. Evidence: TAS. (OMIM:125900)
These phenotypes are associated with the disease diastema, dental medial (OMIM:125900).